- Proximal femoral epiphysiolysis (HP:0006461): Slipped capital femoral epiphysis is defined as a posterior and inferior slippage of the proximal epiphysis of the femur onto the metaphysis (femoral neck), occurring through the physeal plate during the early adolescent growth spurt. Evidence: TAS. (OMIM:182260)
- Hip osteoarthritis (HP:0008843). Evidence: TAS. (OMIM:182260)
- Autosomal dominant inheritance (HP:0000006): A mode of inheritance that is observed for traits related to a gene encoded on one of the autosomes (i.e., the human chromosomes 1-22) in which a trait manifests in heterozygotes. In the context of medical genetics, an autosomal dominant disorder is caused when a single copy of the mutant allele is present. Males and females are affected equally, and can both transmit the disorder with a risk of 50% for each child of inheriting the mutant allele. Evidence: TAS. (OMIM:182260)
These phenotypes are associated with the disease epiphysiolysis of the hip (OMIM:182260).